Phenotypes associated with the disease Congenital enterovirus infection (ORPHA:292):
- Skin rash (HP:0000988): A red eruption of the skin. Evidence: TAS. Frequency: Very frequent (HP:0040281). (ORPHA:292)
- Abnormality of the nervous system (HP:0000707): An abnormality of the nervous system. Evidence: TAS. Frequency: Frequent (HP:0040282). (ORPHA:292)
- Irritability (HP:0000737): An emotional state characterized by negative feelings of heightened frustration, annoyance, or feeling upset, often triggered by internal factors (e.g., fatigue, hunger, unfulfilled desires) or external factors (e.g., social or environmental challenges). Irritability may be unpredictable, and is accompanied by a lowered threshold for emotional reactivity and observable features (speech, facial expressions, or psychomotor activity). Evidence: TAS. Frequency: Frequent (HP:0040282). (ORPHA:292)
- Meningitis (HP:0001287): Inflammation of the meninges. Evidence: TAS. Frequency: Frequent (HP:0040282). (ORPHA:292)
- Thrombocytopenia (HP:0001873): A reduction in the number of circulating thrombocytes. Evidence: TAS. Frequency: Frequent (HP:0040282). (ORPHA:292)
- Fever (HP:0001945): Body temperature elevated above the normal range. Evidence: TAS. Frequency: Frequent (HP:0040282). (ORPHA:292)
- Abnormality of the respiratory system (HP:0002086): An abnormality of the respiratory system, which include the airways, lungs, and the respiratory muscles. Evidence: TAS. Frequency: Frequent (HP:0040282). (ORPHA:292)
- Abnormality of the digestive system (HP:0025031). Evidence: TAS. Frequency: Frequent (HP:0040282). (ORPHA:292)
- Sepsis (HP:0100806): Sepsis is defined as life-threatening organ dysfunction caused by a dysregulated host response to infection. Evidence: TAS. Frequency: Frequent (HP:0040282). (ORPHA:292)
- Cholestasis (HP:0001396): Impairment of bile flow due to obstruction in bile ducts. Evidence: TAS. Frequency: Occasional (HP:0040283). (ORPHA:292)
- Hepatic failure (HP:0001399). Evidence: TAS. Frequency: Occasional (HP:0040283). (ORPHA:292)
- Decreased fetal movement (HP:0001558): An abnormal reduction in quantity or strength of fetal movements. Evidence: TAS. Frequency: Occasional (HP:0040283). (ORPHA:292)
- Polyhydramnios (HP:0001561): The presence of excess amniotic fluid in the uterus during pregnancy. Evidence: TAS. Frequency: Occasional (HP:0040283). (ORPHA:292)
- Premature birth (HP:0001622): The birth of a baby of less than 37 weeks of gestational age. Evidence: TAS. Frequency: Occasional (HP:0040283). (ORPHA:292)
- Cardiomyopathy (HP:0001638): A myocardial disorder in which the heart muscle is structurally and functionally abnormal, in the absence of coronary artery disease, hypertension, valvular disease and congenital heart disease sufficient to cause the observed myocardial abnormality. Evidence: TAS. Frequency: Occasional (HP:0040283). (ORPHA:292)
- Pericardial effusion (HP:0001698): Accumulation of fluid within the pericardium. Evidence: TAS. Frequency: Occasional (HP:0040283). (ORPHA:292)
- Hydrops fetalis (HP:0001789): The abnormal accumulation of fluid in two or more fetal compartments, including ascites, pleural effusion, pericardial effusion, and skin edema. Evidence: TAS. Frequency: Occasional (HP:0040283). (ORPHA:292)
- Fetal ascites (HP:0001791): Accumulation of fluid in the peritoneal cavity during the fetal period. Evidence: TAS. Frequency: Occasional (HP:0040283). (ORPHA:292)
- Decreased total neutrophil count (HP:0001875): Abnormal decrease of absolute number of neutrophils in the blood, per microlitre, compared to a reference range for a given sex and age-group. Evidence: TAS. Frequency: Occasional (HP:0040283). (ORPHA:292)
- Decreased total leukocyte count (HP:0001882): An abnormal decreased number of leukocytes in the blood. Evidence: TAS. Frequency: Occasional (HP:0040283). (ORPHA:292)
- Abnormal bleeding (HP:0001892): An abnormal susceptibility to bleeding, often referred to as a bleeding diathesis. A bleeding diathesis may be related to vascular, platelet and coagulation defects. Evidence: TAS. Frequency: Occasional (HP:0040283). (ORPHA:292)
- Anemia (HP:0001903): A reduction in erythrocytes volume or hemoglobin concentration. Evidence: TAS. Frequency: Occasional (HP:0040283). (ORPHA:292)
- Increased total leukocyte count (HP:0001974): An abnormal increase in the number of leukocytes in the blood. Evidence: TAS. Frequency: Occasional (HP:0040283). (ORPHA:292)
- Respiratory distress (HP:0002098): Respiratory distress is objectively observable as the physical or emotional consequences from the experience of dyspnea. The physical presentation of respiratory distress is generally referred to as labored breathing, while the sensation of respiratory distress is called shortness of breath or dyspnea. Evidence: TAS. Frequency: Occasional (HP:0040283). (ORPHA:292)
- Ventriculomegaly (HP:0002119): An increase in size of the ventricular system of the brain. Evidence: TAS. Frequency: Occasional (HP:0040283). (ORPHA:292)
- Pleural effusion (HP:0002202): The presence of an excessive amount of fluid in the pleural cavity. Evidence: TAS. Frequency: Occasional (HP:0040283). (ORPHA:292)
- Infectious encephalitis (HP:0002383): A disorder of the brain caused by an infectious agent that presents with fever, headache, and an altered level of consciousness. There may also be focal or multifocal neurologic deficits, and focal or generalized seizure activity. Evidence: TAS. Frequency: Occasional (HP:0040283). (ORPHA:292)
- Hypotension (HP:0002615): Low Blood Pressure, vascular hypotension. Evidence: TAS. Frequency: Occasional (HP:0040283). (ORPHA:292)
- Hypoalbuminemia (HP:0003073): The concentration of albumin in the blood circulation is below the lower limit of normal. Evidence: TAS. Frequency: Occasional (HP:0040283). (ORPHA:292)
- Disseminated intravascular coagulation (HP:0005521): Disseminated intravascular coagulation is characterized by the widespread activation of coagulation, which results in the intravascular formation of fibrin and ultimately thrombotic occlusion of small and midsize vessels. Evidence: TAS. Frequency: Occasional (HP:0040283). (ORPHA:292)
- Abnormal skin morphology (HP:0011121): Any morphological abnormality of the skin. Evidence: TAS. Frequency: Occasional (HP:0040283). (ORPHA:292)
- Hepatitis (HP:0012115): Inflammation of the liver. Evidence: TAS. Frequency: Occasional (HP:0040283). (ORPHA:292)
- Neurodevelopmental delay (HP:0012758): Neurodevelopmental delay (NDD) refers to delays in the maturation of the brain and central nervous system; infants and young children with NDD may experience delays in the development of one or more skills including gross motor abilities, fine-motor coordination, language abilities and ability to solve increasingly complex problems. Evidence: TAS. Frequency: Occasional (HP:0040283). (ORPHA:292)
- Myocarditis (HP:0012819): Inflammation of the myocardium. Evidence: TAS. Frequency: Occasional (HP:0040283). (ORPHA:292)
- Fetal distress (HP:0025116): An intrauterine state characterized by suboptimal values in the fetal heart rate, oxygenation of fetal blood, or other parameters indicative of compromise of the fetus. Signs of fetal distress include repetitive variable decelerations, fetal tachycardia or bradycardia, late decelerations, or low biophysical profile. Evidence: TAS. Frequency: Occasional (HP:0040283). (ORPHA:292)
- CSF lymphocytic pleiocytosis (HP:0200149): An increased lymphocyte count in the cerebrospinal fluid. Evidence: TAS. Frequency: Occasional (HP:0040283). (ORPHA:292)
- Hyperammonemia (HP:0001987): An increased concentration of ammonia in the blood. Evidence: TAS. Frequency: Very rare (HP:0040284). (ORPHA:292)
- Hypothermia (HP:0002045): Reduced body temperature due to failed thermoregulation. Evidence: TAS. Frequency: Very rare (HP:0040284). (ORPHA:292)
- Abnormal macrophage morphology (HP:0004311): An abnormality of macrophages. Evidence: TAS. Frequency: Very rare (HP:0040284). (ORPHA:292)